- Joint hypermobility (HP:0001382): The capability that a joint (or a group of joints) has to move, passively and/or actively, beyond normal limits along physiological axes. Evidence: TAS. Frequency: Occasional (HP:0040283). (ORPHA:75496)
- Cryptorchidism (HP:0000028): Testis in inguinal canal. That is, absence of one or both testes from the scrotum owing to failure of the testis or testes to descend through the inguinal canal to the scrotum. Evidence: TAS. Frequency: Very frequent (HP:0040281). (ORPHA:75496)
- Gingivitis (HP:0000230): Inflammation of the gingiva. Evidence: TAS. Frequency: Very frequent (HP:0040281). (ORPHA:75496)
- Macrocephaly (HP:0000256): Occipitofrontal (head) circumference greater than 97th centile compared to appropriate, age matched, sex-matched normal standards. Alternatively, a apparently increased size of the cranium. Evidence: TAS. Frequency: Very frequent (HP:0040281). (ORPHA:75496)
- Epicanthus (HP:0000286): A fold of skin starting above the medial aspect of the upper eyelid and arching downward to cover, pass in front of and lateral to the medial canthus. Evidence: TAS. Frequency: Very frequent (HP:0040281). (ORPHA:75496)
- Thin skin (HP:0000963): Reduction in thickness of the skin, generally associated with a loss of suppleness and elasticity of the skin. Evidence: TAS. Frequency: Very frequent (HP:0040281). (ORPHA:75496)
- Cutis laxa (HP:0000973): Wrinkled, redundant, inelastic and sagging skin. Evidence: TAS. Frequency: Very frequent (HP:0040281). (ORPHA:75496)
- Hyperextensible skin (HP:0000974): A condition in which the skin can be stretched beyond normal, and then returns to its initial position. Evidence: TAS. Frequency: Very frequent (HP:0040281). (ORPHA:75496)
- Arachnodactyly (HP:0001166): Abnormally long and slender fingers (spider fingers). Evidence: TAS. Frequency: Very frequent (HP:0040281). (ORPHA:75496)
- Hypotonia (HP:0001252): Hypotonia is an abnormally low muscle tone (the amount of tension or resistance to movement in a muscle). Even when relaxed, muscles have a continuous and passive partial contraction which provides some resistance to passive stretching. Hypotonia thus manifests as diminished resistance to passive stretching. Hypotonia is not the same as muscle weakness, although the two conditions can co-exist. Evidence: TAS. Frequency: Very frequent (HP:0040281). (ORPHA:75496)
- Global developmental delay (HP:0001263): A delay in the achievement of motor or mental milestones in the domains of development of a child, including motor skills, speech and language, cognitive skills, and social and emotional skills. This term should only be used to describe children younger than five years of age. Evidence: TAS. Frequency: Very frequent (HP:0040281). (ORPHA:75496)
- Flexion contracture (HP:0001371): A flexion contracture is a bent (flexed) joint that cannot be straightened actively or passively. It is thus a chronic loss of joint motion due to structural changes in muscle, tendons, ligaments, or skin that prevents normal movement of joints. Evidence: TAS. Frequency: Very frequent (HP:0040281). (ORPHA:75496)
- Growth delay (HP:0001510): A deficiency or slowing down of growth pre- and postnatally. Evidence: TAS. Frequency: Very frequent (HP:0040281). (ORPHA:75496)
- Pulmonic stenosis (HP:0001642): A narrowing of the right ventricular outflow tract that can occur at the pulmonary valve (valvular stenosis), below the pulmonary valve (infundibular stenosis), or above the pulmonary valve (supravalvar stenosis). Evidence: TAS. Frequency: Very frequent (HP:0040281). (ORPHA:75496)
- Aortic valve stenosis (HP:0001650): The presence of a stenosis (narrowing) of the aortic valve. Evidence: TAS. Frequency: Very frequent (HP:0040281). (ORPHA:75496)
- Pes planus (HP:0001763): A foot where the longitudinal arch of the foot is in contact with the ground or floor when the individual is standing; or, in a patient lying supine, a foot where the arch is in contact with the surface of a flat board pressed against the sole of the foot by the examiner with a pressure similar to that expected from weight bearing; or, the height of the arch is reduced. Evidence: TAS. Frequency: Very frequent (HP:0040281). (ORPHA:75496)
- Short stature (HP:0004322): A height below that which is expected according to age and gender norms. Although there is no universally accepted definition of short stature, many refer to "short stature" as height more than 2 standard deviations below the mean for age and gender (or below the 3rd percentile for age and gender dependent norms). Evidence: TAS. Frequency: Very frequent (HP:0040281). (ORPHA:75496)
- Progeroid facial appearance (HP:0005328): A degree of wrinkling of the facial skin that is more than expected for the age of the individual, leading to a prematurely aged appearance. Evidence: TAS. Frequency: Very frequent (HP:0040281). (ORPHA:75496)
- Palmoplantar cutis gyrata (HP:0007469): Cutis gyrata of palms and soles. Evidence: TAS. Frequency: Very frequent (HP:0040281). (ORPHA:75496)
- Lipodystrophy (HP:0009125): Degenerative changes of the fat tissue. Evidence: TAS. Frequency: Very frequent (HP:0040281). (ORPHA:75496)
- Long toe (HP:0010511): Toes that appear disproportionately long compared to the foot. Evidence: TAS. Frequency: Very frequent (HP:0040281). (ORPHA:75496)
- Testicular torsion (HP:0100813): Testicular torsion is when the spermatic cord to a testicle twists, cutting off the blood supply. The most common symptom is acute testicular pain. Evidence: TAS. Frequency: Very frequent (HP:0040281). (ORPHA:75496)
- Narrow mouth (HP:0000160): Distance between the commissures of the mouth more than 2 SD below the mean. Alternatively, an apparently decreased width of the oral aperture (subjective). Evidence: TAS. Frequency: Frequent (HP:0040282). (ORPHA:75496)
- Wide nasal bridge (HP:0000431): Increased breadth of the nasal bridge (and with it, the nasal root). Evidence: TAS. Frequency: Frequent (HP:0040282). (ORPHA:75496)
- Telecanthus (HP:0000506): Distance between the inner canthi more than two standard deviations above the mean (objective); or, apparently increased distance between the inner canthi. Evidence: TAS. Frequency: Frequent (HP:0040282). (ORPHA:75496)
- Sparse eyelashes (HP:0000653): Decreased density/number of eyelashes. Evidence: TAS. Frequency: Frequent (HP:0040282). (ORPHA:75496)
- Osteopenia (HP:0000938): Osteopenia is a term to define bone density that is not normal but also not as low as osteoporosis. By definition from the World Health Organization osteopenia is defined by bone densitometry as a T score -1 to -2.5. Evidence: TAS. Frequency: Frequent (HP:0040282). (ORPHA:75496)
- Atypical scarring of skin (HP:0000987): Atypically scarred skin . Evidence: TAS. Frequency: Frequent (HP:0040282). (ORPHA:75496)
- Abnormal skin pigmentation (HP:0001000): An abnormality of the pigmentation of the skin. Evidence: TAS. Frequency: Frequent (HP:0040282). (ORPHA:75496)
- Atrophic scars (HP:0001075): Scars that form a depression compared to the level of the surrounding skin because of damage to the collagen, fat or other tissues below the skin. Evidence: TAS. Frequency: Frequent (HP:0040282). (ORPHA:75496)
- Abnormal facial shape (HP:0001999): An abnormal morphology (form) of the face or its components. Evidence: TAS. Frequency: Frequent (HP:0040282). (ORPHA:75496)
- Sparse scalp hair (HP:0002209): Decreased number of hairs per unit area of skin of the scalp. Evidence: TAS. Frequency: Frequent (HP:0040282). (ORPHA:75496)
- Skeletal dysplasia (HP:0002652): A general term describing features characterized by abnormal development of bones and connective tissues. Evidence: TAS. Frequency: Frequent (HP:0040282). (ORPHA:75496)
- Skeletal muscle atrophy (HP:0003202): The presence of skeletal muscular atrophy (which is also known as amyotrophy). Evidence: TAS. Frequency: Frequent (HP:0040282). (ORPHA:75496)
- Sparse eyebrow (HP:0045075): Decreased density/number of eyebrow hairs. Evidence: TAS. Frequency: Frequent (HP:0040282). (ORPHA:75496)
- Kyphoscoliosis (HP:0002751): An abnormal curvature of the spine in both a coronal (lateral) and sagittal (back-to-front) plane. Evidence: TAS. Frequency: Occasional (HP:0040283). (ORPHA:75496)
- Abnormal primary tooth morphology (HP:0006481): Any abnormality of the primary tooth. Evidence: TAS. Frequency: Occasional (HP:0040283). (ORPHA:75496)
These phenotypes are associated with the disease B4GALT7-related spondylodysplastic Ehlers-Danlos syndrome (ORPHA:75496).